- Coiled sperm flagella (HP:0032560): Sperm cells whose flagella are twisted (coiled). Evidence: PCS. (PMID:31735292)
- Microcephalic sperm head (HP:0032561): Decreased size of the head of sperm. Evidence: PCS. (PMID:31735292)
- Male infertility (HP:0003251). Evidence: PCS. Frequency: 5/5. (PMID:31735292)
- Tapered sperm head (HP:0032562): Sperm with cigar-shaped heads that gradually dimish in diameter (taper). Evidence: PCS. (PMID:31735292)
- Autosomal recessive inheritance (HP:0000007): A mode of inheritance that is observed for traits related to a gene encoded on one of the autosomes (i.e., the human chromosomes 1-22) in which a trait manifests in individuals with two pathogenic alleles, either homozygotes (two copies of the same mutant allele) or compound heterozygotes (whereby each copy of a gene has a distinct mutant allele). Evidence: PCS. (PMID:31735292)
- Reduced sperm motility (HP:0012207): An abnormal reduction in the mobility of ejaculated sperm. Evidence: PCS. Frequency: 5/5. (PMID:31735292)
- Absent sperm flagella (HP:0032558): Sperm cells lacking flagella. Evidence: PCS. (PMID:31735292)
- Short sperm flagella (HP:0032559): Sperm cells with abnormally short flagella. Evidence: PCS. (PMID:31735292)
These phenotypes are associated with the disease spermatogenic failure 42 (OMIM:618745).